Phenotypes associated with the disease kuru, susceptibility to (OMIM:245300):
- Abnormality of eye movement (HP:0000496): An abnormality in voluntary or involuntary eye movements or their control. Evidence: IEA. (OMIM:245300)
- Ataxia (HP:0001251): Ataxia refers to impaired coordination of voluntary muscle movement. Cerebellar ataxia refers to ataxia due to dysfunction of the cerebellum. This causes a variety of elementary neurological deficits including asynergy (lack of coordination between muscles, limbs and joints), dysmetria (lack of ability to judge distances that can lead to under- or overshoot in grasping movements), and dysdiadochokinesia (inability to perform rapid movements requiring antagonizing muscle groups to be switched on and off repeatedly). Evidence: IEA. (OMIM:245300)
- Neurodegeneration (HP:0002180): Progressive loss of neural cells and tissue. Evidence: TAS. (OMIM:245300)
- Unsteady gait (HP:0002317). Evidence: TAS. (OMIM:245300)
- Mental deterioration (HP:0001268): Loss of previously present mental abilities, generally in adults. Evidence: IEA. (OMIM:245300)